- Lip pit (HP:0100267): A depression located on a lip. Evidence: TAS. Frequency: Very frequent (HP:0040281). (ORPHA:141291)
- Abnormality of the face (HP:0000271): An abnormality of the face. Evidence: TAS. Frequency: Frequent (HP:0040282). (ORPHA:141291)
- Hypernasal speech (HP:0001611): A type of speech characterized by the presence of an abnormally increased nasal airflow during speech associated with structural abnormality of the nasal passages. Evidence: TAS. Frequency: Frequent (HP:0040282). (ORPHA:141291)
- Abnormal pattern of respiration (HP:0002793): An anomaly of the rhythm or depth of breathing. Evidence: TAS. Frequency: Frequent (HP:0040282). (ORPHA:141291)
- Abnormal nasal morphology (HP:0005105). Evidence: TAS. Frequency: Frequent (HP:0040282). (ORPHA:141291)
- Impaired mastication (HP:0005216): An abnormal reduction in the ability to masticate (chew), i.e., in the ability to crush and ground food in preparation for swallowing. Evidence: TAS. Frequency: Frequent (HP:0040282). (ORPHA:141291)
- Disturbance of facial expression (HP:0005324): An abnormality of the gestures or movements executed with the facial muscles with which emotions such as fear, joy, sadness, surprise, and disgust can be expressed. Evidence: TAS. Frequency: Frequent (HP:0040282). (ORPHA:141291)
- Speech articulation difficulties (HP:0009088): Impairment in the physical production of speech sounds. Evidence: TAS. Frequency: Frequent (HP:0040282). (ORPHA:141291)
- Abnormality of masticatory muscle (HP:0410011): Any abnormality of the masticatory muscle. Evidence: TAS. Frequency: Frequent (HP:0040282). (ORPHA:141291)
- Abnormal nasal septum morphology (HP:0000419): An abnormality of the nasal septum. Evidence: TAS. Frequency: Occasional (HP:0040283). (ORPHA:141291)
- Hypodontia (HP:0000668): The absence of five or less teeth from the normal series by a failure to develop. Evidence: TAS. Frequency: Occasional (HP:0040283). (ORPHA:141291)
- Dysphagia (HP:0002015): Difficulty in swallowing. Evidence: TAS. Frequency: Occasional (HP:0040283). (ORPHA:141291)
These phenotypes are associated with the disease Cleft lip and alveolus (ORPHA:141291).